Phenotypes associated with the disease neurodegeneration with brain iron accumulation 7 (OMIM:617916):
- Progressive (HP:0003676): Applies to a disease manifestation that increases in scope or severity over the course of time, i.e., that worsens with age. Evidence: PCS. (PMID:29395073)
- Dystonia (HP:0001332): An abnormally increased muscular tone that causes fixed abnormal postures. There is a slow, intermittent twisting motion that leads to exaggerated turning and posture of the extremities and trunk. Evidence: PCS. Frequency: 1/2. (PMID:29395073)
- Dysmetria (HP:0001310): A type of ataxia characterized by the inability to carry out movements with the correct range and motion across the plane of more than one joint related to incorrect estimation of the distances required for targeted movements. Evidence: PCS. Frequency: 1/2. (PMID:29395073)
- Cerebellar atrophy (HP:0001272): Cerebellar atrophy is defined as a cerebellum with initially normal structures, in a posterior fossa with normal size, which displays enlarged fissures (interfolial spaces) in comparison to the foliae secondary to loss of tissue. Cerebellar atrophy implies irreversible loss of tissue and result from an ongoing progressive disease until a final stage is reached or a single injury, e.g. an intoxication or infectious event. Evidence: PCS. Frequency: 2/2. (PMID:29395073)
- Hypotonia (HP:0001252): Hypotonia is an abnormally low muscle tone (the amount of tension or resistance to movement in a muscle). Even when relaxed, muscles have a continuous and passive partial contraction which provides some resistance to passive stretching. Hypotonia thus manifests as diminished resistance to passive stretching. Hypotonia is not the same as muscle weakness, although the two conditions can co-exist. Evidence: PCS. Frequency: 1/2. (PMID:29395073)
- Infantile onset (HP:0003593): Onset of signs or symptoms of disease between 28 days to one year of life. Evidence: PCS. Frequency: 2/2. (PMID:29395073)
- Ataxia (HP:0001251): Ataxia refers to impaired coordination of voluntary muscle movement. Cerebellar ataxia refers to ataxia due to dysfunction of the cerebellum. This causes a variety of elementary neurological deficits including asynergy (lack of coordination between muscles, limbs and joints), dysmetria (lack of ability to judge distances that can lead to under- or overshoot in grasping movements), and dysdiadochokinesia (inability to perform rapid movements requiring antagonizing muscle groups to be switched on and off repeatedly). Evidence: PCS. Frequency: 2/2. (PMID:29395073)
- Lower limb spasticity (HP:0002061): Spasticity (velocity-dependent increase in tonic stretch reflexes with increased muscle tone and hyperexcitable tendon reflexes) in the muscles of the lower limbs, hips, and pelvis. Evidence: PCS. Frequency: 1/2. (PMID:29395073)
- Motor delay (HP:0001270): A type of Developmental delay characterized by a delay in acquiring motor skills. Evidence: PCS. Frequency: 1/2. (PMID:29395073)
- Increased circulating very long-chain fatty acid concentration (HP:0033643): Increased concentration of very long-chain fatty acids in the blood circulation. Very long-chain fatty acids are fatty acids (FAs) with a chain-length of 22 or more carbons. Evidence: PCS. Frequency: 1/2. (PMID:29395073)
- Nystagmus (HP:0000639): Rhythmic, involuntary oscillations of one or both eyes related to abnormality in fixation, conjugate gaze, or vestibular mechanisms. Evidence: PCS. Frequency: 1/2. (PMID:29395073)
- Leukodystrophy (HP:0002415): Leukodystrophy refers to deterioration of white matter of the brain resulting from degeneration of myelin sheaths in the CNS. Their basic defect is directly related to the synthesis and maintenance of myelin membranes. Symmetric white matter involvement at MRI is a typical finding in patients with leukodystrophies. Evidence: PCS. Frequency: 1/2. (PMID:29395073)
- Brisk reflexes (HP:0001348): Tendon reflexes that are noticeably more active than usual (conventionally denoted 3+ on clinical examination). Brisk reflexes may or may not indicate a neurological lesion. They are distinguished from hyperreflexia by the fact that hyerreflexia is characterized by hyperactive repeating (clonic) reflexes, which are considered to be always abnormal. Evidence: PCS. Frequency: 1/2. (PMID:29395073)
- Axial hypotonia (HP:0008936): Muscular hypotonia (abnormally low muscle tone) affecting the musculature of the trunk. Evidence: PCS. Frequency: 1/2. (PMID:29395073)
- Dysphagia (HP:0002015): Difficulty in swallowing. Evidence: PCS. Frequency: 1/2. (PMID:29395073)
- Cerebral atrophy (HP:0002059): Atrophy (wasting, decrease in size of cells or tissue) affecting the cerebrum. Evidence: PCS. Frequency: 1/2. (PMID:29395073)
- Delayed speech and language development (HP:0000750): A degree of language development that is significantly below the norm for a child of a specified age. Evidence: PCS. Frequency: 2/2. (PMID:29395073)
- Pes cavus (HP:0001761): An increase in height of the medial longitudinal arch of the foot that does not flatten on weight bearing (i.e., a distinctly hollow form of the sole of the foot when it is bearing weight). Evidence: PCS. Frequency: 1/2. (PMID:29395073)
- Hypoplasia of the corpus callosum (HP:0002079): Underdevelopment of the corpus callosum. Evidence: PCS. Frequency: 2/2. (PMID:29395073)
- Dysarthria (HP:0001260): Dysarthric speech is a general description referring to a neurological speech disorder characterized by poor articulation. Depending on the involved neurological structures, dysarthria may be further classified as spastic, flaccid, ataxic, hyperkinetic and hypokinetic, or mixed. Evidence: PCS. Frequency: 1/2. (PMID:29395073)
- Iron accumulation in brain (HP:0012675): An abnormal build up of iron (Fe) in brain tissue. Evidence: PCS. Frequency: 2/2. (PMID:29395073)
- Autosomal recessive inheritance (HP:0000007): A mode of inheritance that is observed for traits related to a gene encoded on one of the autosomes (i.e., the human chromosomes 1-22) in which a trait manifests in individuals with two pathogenic alleles, either homozygotes (two copies of the same mutant allele) or compound heterozygotes (whereby each copy of a gene has a distinct mutant allele). Evidence: PCS. (PMID:29395073)
- Loss of ambulation (HP:0002505): Inability to walk in a person who previous had the ability to walk. Evidence: PCS. Frequency: 2/2. (PMID:29395073)
- Sensory neuropathy (HP:0000763): Peripheral neuropathy affecting the sensory nerves. Evidence: PCS. Frequency: 1/2. (PMID:29395073)
- Spinocerebellar tract degeneration (HP:0002503). Evidence: PCS. Frequency: 1/2. (PMID:29395073)
- Tremor (HP:0001337): An unintentional, oscillating to-and-fro muscle movement about a joint axis. Evidence: PCS. Frequency: 1/2. (PMID:29395073)